- Macroglossia (HP:0000158): Increased length and width of the tongue. Evidence: TAS. Frequency: Very frequent (HP:0040281). (ORPHA:369950)
- Narrow mouth (HP:0000160): Distance between the commissures of the mouth more than 2 SD below the mean. Alternatively, an apparently decreased width of the oral aperture (subjective). Evidence: TAS. Frequency: Occasional (HP:0040283). (ORPHA:369950)
- Thick lower lip vermilion (HP:0000179): Increased thickness of the lower lip, leading to a prominent appearance of the lower lip. The height of the vermilion of the lower lip in the midline is more than 2 SD above the mean. Alternatively, an apparently increased height of the vermilion of the lower lip in the frontal view (subjective). Evidence: TAS. Frequency: Occasional (HP:0040283). (ORPHA:369950)
- Macrocephaly (HP:0000256): Occipitofrontal (head) circumference greater than 97th centile compared to appropriate, age matched, sex-matched normal standards. Alternatively, a apparently increased size of the cranium. Evidence: TAS. Frequency: Very frequent (HP:0040281). (ORPHA:369950)
- Coarse facial features (HP:0000280): Absence of fine and sharp appearance of brows, nose, lips, mouth, and chin, usually because of rounded and heavy features or thickened skin with or without thickening of subcutaneous and bony tissues. Evidence: TAS. Frequency: Occasional (HP:0040283). (ORPHA:369950)
- Epicanthus (HP:0000286): A fold of skin starting above the medial aspect of the upper eyelid and arching downward to cover, pass in front of and lateral to the medial canthus. Evidence: TAS. Frequency: Occasional (HP:0040283). (ORPHA:369950)
- Round face (HP:0000311): The facial appearance is more circular than usual as viewed from the front. Evidence: TAS. Frequency: Very frequent (HP:0040281). (ORPHA:369950)
- Hypertelorism (HP:0000316): Interpupillary distance more than 2 SD above the mean (alternatively, the appearance of an increased interpupillary distance or widely spaced eyes). Evidence: TAS. Frequency: Very frequent (HP:0040281). (ORPHA:369950)
- Micrognathia (HP:0000347): Developmental hypoplasia of the mandible. Evidence: TAS. Frequency: Occasional (HP:0040283). (ORPHA:369950)
- Posteriorly rotated ears (HP:0000358): A type of abnormal location of the ears in which the position of the ears is characterized by posterior rotation (the superior part of the ears is rotated towards the back of the head, and the inferior part of the ears towards the front). Evidence: TAS. Frequency: Occasional (HP:0040283). (ORPHA:369950)
- Hearing impairment (HP:0000365): A decreased magnitude of the sensory perception of sound. Evidence: TAS. Frequency: Very frequent (HP:0040281). (ORPHA:369950)
- Convex nasal ridge (HP:0000444): Nasal ridge curving anteriorly to an imaginary line that connects the nasal root and tip. The nose appears often also prominent, and the columella low. Evidence: TAS. Frequency: Occasional (HP:0040283). (ORPHA:369950)
- Astigmatism (HP:0000483): A type of refraction error associated with abnormal curvatures on the anterior and/or posterior surface of the cornea. Evidence: TAS. Frequency: Very frequent (HP:0040281). (ORPHA:369950)
- Strabismus (HP:0000486): A misalignment of the eyes so that the visual axes deviate from bifoveal fixation. The classification of strabismus may be based on a number of features including the relative position of the eyes, whether the deviation is latent or manifest, intermittent or constant, concomitant or otherwise and according to the age of onset and the relevance of any associated refractive error. Evidence: TAS. Frequency: Very frequent (HP:0040281). (ORPHA:369950)
- Downslanted palpebral fissures (HP:0000494): The palpebral fissure inclination is more than two standard deviations below the mean. Evidence: TAS. Frequency: Very frequent (HP:0040281). (ORPHA:369950)
- Ptosis (HP:0000508): The upper eyelid margin is positioned 3 mm or more lower than usual and covers the superior portion of the iris (objective); or, the upper lid margin obscures at least part of the pupil (subjective). Evidence: TAS. Frequency: Very frequent (HP:0040281). (ORPHA:369950)
- Thick eyebrow (HP:0000574): Increased density/number and/or increased diameter of eyebrow hairs. Evidence: TAS. Frequency: Occasional (HP:0040283). (ORPHA:369950)
- Exotropia (HP:0000577): A form of strabismus with one or both eyes deviated outward. Evidence: TAS. Frequency: Very frequent (HP:0040281). (ORPHA:369950)
- Periorbital fullness (HP:0000629): Increase in periorbital soft tissue. Evidence: TAS. Frequency: Very frequent (HP:0040281). (ORPHA:369950)
- Amblyopia (HP:0000646): Reduced visual acuity that is uncorrectable by lenses in the absence of detectable anatomic defects in the eye or visual pathways. Evidence: TAS. Frequency: Very frequent (HP:0040281). (ORPHA:369950)
- Delayed eruption of teeth (HP:0000684): Delayed tooth eruption, which can be defined as tooth eruption more than 2 SD beyond the mean eruption age. Evidence: TAS. Frequency: Very frequent (HP:0040281). (ORPHA:369950)
- Aggressive behavior (HP:0000718): Behavior or an act aimed at harming a person, animal, or physical property (e.g., acts of physical violence; shouting, swearing, and using harsh language; slashing someone's tires). Evidence: TAS. Frequency: Occasional (HP:0040283). (ORPHA:369950)
- Compulsive behaviors (HP:0000722): Behavior that consists of repetitive acts, characterized by the feeling that one "has to" perform them, while being aware that these acts are not in line with one's overall goal. Evidence: TAS. Frequency: Occasional (HP:0040283). (ORPHA:369950)
- Delayed speech and language development (HP:0000750): A degree of language development that is significantly below the norm for a child of a specified age. Evidence: TAS. Frequency: Very frequent (HP:0040281). (ORPHA:369950)
- Global developmental delay (HP:0001263): A delay in the achievement of motor or mental milestones in the domains of development of a child, including motor skills, speech and language, cognitive skills, and social and emotional skills. This term should only be used to describe children younger than five years of age. Evidence: TAS. Frequency: Very frequent (HP:0040281). (ORPHA:369950)
- Enuresis (HP:0000805): Lack of the ability to control the urinary bladder leading to involuntary urination at an age where control of the bladder should already be possible. Evidence: TAS. Frequency: Very frequent (HP:0040281). (ORPHA:369950)
- Eczematoid dermatitis (HP:0000964): Eczema is a form of dermatitis that is characterized by scaly, pruritic, erythematous lesions located on flexural surfaces. Evidence: TAS. Frequency: Very frequent (HP:0040281). (ORPHA:369950)
- Seborrheic dermatitis (HP:0001051): Seborrheic dermatitis is a form of eczema which is closely related to dandruff. It causes dry or greasy peeling of the scalp, eyebrows, and face, and sometimes trunk. Evidence: TAS. Frequency: Occasional (HP:0040283). (ORPHA:369950)
- Intellectual disability (HP:0001249): The term intellectual disability or intellectual developmental disorder is used to describe significantly sub-average intellectual and adaptive functioning based on clinical assessment and as measured by individually administered, appropriately normed, standardized and validated tests of intellectual functioning and adaptive behavior, with onset during the developmental period from infancy through adolescence. Evidence: TAS. Frequency: Very frequent (HP:0040281). (ORPHA:369950)
- Seizure (HP:0001250): A seizure is an intermittent abnormality of nervous system physiology characterized by a transient occurrence of signs and/or symptoms due to abnormal excessive or synchronous neuronal activity in the brain. Evidence: TAS. Frequency: Very frequent (HP:0040281). (ORPHA:369950)
- Hemiparesis (HP:0001269): Loss of strength in the arm, leg, and sometimes face on one side of the body. Hemiplegia refers to a complete loss of strength, whereas hemiparesis refers to an incomplete loss of strength. Evidence: TAS. Frequency: Very frequent (HP:0040281). (ORPHA:369950)
- Generalized hypotonia (HP:0001290): Generalized muscular hypotonia (abnormally low muscle tone). Evidence: TAS. Frequency: Very frequent (HP:0040281). (ORPHA:369950)
- Failure to thrive (HP:0001508): Failure to thrive (FTT) refers to a child whose physical growth is substantially below the norm. Evidence: TAS. Frequency: Very frequent (HP:0040281). (ORPHA:369950)
- Obesity (HP:0001513): Accumulation of substantial excess body fat. Evidence: TAS. Frequency: Very frequent (HP:0040281). (ORPHA:369950)
- Mitral valve prolapse (HP:0001634): One or both of the leaflets (cusps) of the mitral valve bulges back into the left atrium upon contraction of the left ventricle. Evidence: TAS. Frequency: Very frequent (HP:0040281). (ORPHA:369950)
- Wolff-Parkinson-White syndrome (HP:0001716): A disorder of the cardiac conduction system of the heart characterized by ventricular preexcitation due to the presence of an abnormal accessory atrioventricular electrical conduction pathway. Evidence: TAS. Frequency: Very frequent (HP:0040281). (ORPHA:369950)
- Abnormal foot morphology (HP:0001760): An abnormality of the skeleton of foot. Evidence: TAS. Frequency: Very frequent (HP:0040281). (ORPHA:369950)
- Pes planus (HP:0001763): A foot where the longitudinal arch of the foot is in contact with the ground or floor when the individual is standing; or, in a patient lying supine, a foot where the arch is in contact with the surface of a flat board pressed against the sole of the foot by the examiner with a pressure similar to that expected from weight bearing; or, the height of the arch is reduced. Evidence: TAS. Frequency: Occasional (HP:0040283). (ORPHA:369950)
- Large forehead (HP:0002003). Evidence: TAS. Frequency: Occasional (HP:0040283). (ORPHA:369950)
- Constipation (HP:0002019): Infrequent or difficult evacuation of feces. Evidence: TAS. Frequency: Very frequent (HP:0040281). (ORPHA:369950)
- Heat intolerance (HP:0002046): The inability to maintain a comfortable body temperature in warm or hot weather. Evidence: TAS. Frequency: Very frequent (HP:0040281). (ORPHA:369950)
- Hypoplasia of the corpus callosum (HP:0002079): Underdevelopment of the corpus callosum. Evidence: TAS. Frequency: Occasional (HP:0040283). (ORPHA:369950)
- Broad-based gait (HP:0002136): An abnormal gait pattern in which persons stand and walk with their feet spaced widely apart. This is often a component of cerebellar ataxia. Evidence: TAS. Frequency: Very frequent (HP:0040281). (ORPHA:369950)
- High, narrow palate (HP:0002705): The presence of a high and narrow palate. Evidence: TAS. Frequency: Very frequent (HP:0040281). (ORPHA:369950)
- Inverted nipples (HP:0003186): The presence of nipples that instead of pointing outward are retracted inwards. Evidence: TAS. Frequency: Occasional (HP:0040283). (ORPHA:369950)
- Clinodactyly of the 5th finger (HP:0004209): Clinodactyly refers to a bending or curvature of the fifth finger in the radial direction (i.e., towards the 4th finger). Evidence: TAS. Frequency: Occasional (HP:0040283). (ORPHA:369950)
- Abnormal dental morphology (HP:0006482): An abnormality of the morphology of the tooth. Evidence: TAS. Frequency: Very frequent (HP:0040281). (ORPHA:369950)
- Underdeveloped superior crus of antihelix (HP:0011246): Decreased protrusion of the superior crus relative to the prominence of a normal antihelix stem. Evidence: TAS. Frequency: Occasional (HP:0040283). (ORPHA:369950)
- Abnormality of the pineal gland (HP:0012680): An anomaly of the pineal gland,a small endocrine gland in the brain that produces melatonin. Evidence: TAS. Frequency: Very frequent (HP:0040281). (ORPHA:369950)
- Tongue thrusting (HP:0100703): Pressing forward of the tongue in the mouth, a retained motoric habit from infantile swallowing patterns. Evidence: TAS. Frequency: Very frequent (HP:0040281). (ORPHA:369950)
These phenotypes are associated with the disease Intellectual disability-seizures-macrocephaly-obesity syndrome (ORPHA:369950).